- Cerebellar vermis hypoplasia (HP:0001320): Underdevelopment of the vermis of cerebellum. Evidence: PCS. (PMID:18711368)
- Microcephaly (HP:0000252): Head circumference below 2 standard deviations below the mean for age and gender. Evidence: PCS. (PMID:18711368)
- Dystonia (HP:0001332): An abnormally increased muscular tone that causes fixed abnormal postures. There is a slow, intermittent twisting motion that leads to exaggerated turning and posture of the extremities and trunk. Evidence: PCS. (PMID:18711368)
- Cerebellar hemisphere hypoplasia (HP:0100307). Evidence: PCS. (PMID:18711368)
- Chorea (HP:0002072): Chorea (Greek for 'dance') refers to widespread arrhythmic involuntary movements of a forcible, jerky and restless fashion. It is a random-appearing sequence of one or more discrete involuntary movements or movement fragments. Movements appear random because of variability in timing, duration or location. Each movement may have a distinct start and end. However, movements may be strung together and thus may appear to flow randomly from one muscle group to another. Chorea can involve the trunk, neck, face, tongue, and extremities. Evidence: PCS. (PMID:18711368)
- Autosomal recessive inheritance (HP:0000007): A mode of inheritance that is observed for traits related to a gene encoded on one of the autosomes (i.e., the human chromosomes 1-22) in which a trait manifests in individuals with two pathogenic alleles, either homozygotes (two copies of the same mutant allele) or compound heterozygotes (whereby each copy of a gene has a distinct mutant allele). Evidence: PCS. (PMID:18711368)
- Visual impairment (HP:0000505): Visual impairment (or vision impairment) is vision loss (of a person) to such a degree as to qualify as an additional support need through a significant limitation of visual capability resulting from either disease, trauma, or congenital or degenerative conditions that cannot be corrected by conventional means, such as refractive correction, medication, or surgery. Evidence: PCS. (PMID:18711368)
These phenotypes are associated with the disease pontocerebellar hypoplasia type 2C (OMIM:612390).